- Regional abnormality of skin (HP:0011356): An abnormality of the skin that is restricted to a particular body region. Evidence: TAS. Frequency: Frequent (HP:0040282). (ORPHA:293812)
- Erythema (HP:0010783): Redness of the skin, caused by hyperemia of the capillaries in the lower layers of the skin. Evidence: TAS. Frequency: Very frequent (HP:0040281). (ORPHA:293812)
- Erythematous plaque (HP:0025474): A plaque (a solid, raised, plateau-like (flat-topped) lesion greater than 1 cm in diameter) with a red or reddish color often associated with inflammation or irritation. Evidence: TAS. Frequency: Frequent (HP:0040282). (ORPHA:293812)
- Adverse drug response (HP:0020172): An unpleasant or harmful reaction resulting from treatment with a drug. Evidence: TAS. Frequency: Very frequent (HP:0040281). (ORPHA:293812)
- Hyperpigmentation of the skin (HP:0000953): A darkening of the skin related to an increase in melanin production and deposition. Evidence: TAS. Frequency: Occasional (HP:0040283). (ORPHA:293812)
- Oral ulcer (HP:0000155): Erosion of the mucous mebrane of the mouth with local excavation of the surface, resulting from the sloughing of inflammatory necrotic tissue. Evidence: TAS. Frequency: Occasional (HP:0040283). (ORPHA:293812)
- Generalized abnormality of skin (HP:0011354): An abnormality of the skin that is not localized to any one particular region. Evidence: TAS. Frequency: Very rare (HP:0040284). (ORPHA:293812)
- Stomatitis (HP:0010280): Stomatitis is an inflammation of the mucous membranes of any of the structures in the mouth. Evidence: TAS. Frequency: Occasional (HP:0040283). (ORPHA:293812)
- Crusting erythematous dermatitis (HP:0007473). Evidence: TAS. Frequency: Very rare (HP:0040284). (ORPHA:293812)
- Lamina lucida cleavage (HP:0003341): The formation of bullae (blisters) with cleavage in the lamina lucida layer of the skin. Evidence: TAS. Frequency: Frequent (HP:0040282). (ORPHA:293812)
- Drug allergy (HP:0410323): Hypersensitivity in form of an adverse immune reaction against drugs. Evidence: TAS. Frequency: Very frequent (HP:0040281). (ORPHA:293812)
- Abnormal blistering of the skin (HP:0008066): The presence of one or more bullae on the skin, defined as fluid-filled blisters more than 5 mm in diameter with thin walls. Evidence: TAS. Frequency: Occasional (HP:0040283). (ORPHA:293812)
- Skin erosion (HP:0200041): A discontinuity of the skin exhibiting incomplete loss of the epidermis, a lesion that is moist, circumscribed, and usually depressed. Evidence: TAS. Frequency: Occasional (HP:0040283). (ORPHA:293812)
- Vaginal mucosal ulceration (HP:0032565). Evidence: TAS. Frequency: Very rare (HP:0040284). (ORPHA:293812)
- Skin detachment (HP:0032156): Loss of sections of skin either spontaneously or after gentle handling. Evidence: TAS. Frequency: Occasional (HP:0040283). (ORPHA:293812)
- Fever (HP:0001945): Body temperature elevated above the normal range. Evidence: TAS. Frequency: Occasional (HP:0040283). (ORPHA:293812)
- Chills (HP:0025143): A sudden sensation of feeling cold. Evidence: TAS. Frequency: Very rare (HP:0040284). (ORPHA:293812)
- Fatigue (HP:0012378): A subjective feeling of tiredness characterized by a lack of energy and motivation. Evidence: TAS. Frequency: Occasional (HP:0040283). (ORPHA:293812)
These phenotypes are associated with the disease Fixed drug eruption (ORPHA:293812).